- Female infertility (HP:0008222). Evidence: PCS. Frequency: 2/2. (PMID:34611029)
- Young adult onset (HP:0011462): Onset of disease at the age of between 16 and 40 years. Evidence: PCS. Frequency: 2/2. (PMID:34611029)
- Autosomal recessive inheritance (HP:0000007): A mode of inheritance that is observed for traits related to a gene encoded on one of the autosomes (i.e., the human chromosomes 1-22) in which a trait manifests in individuals with two pathogenic alleles, either homozygotes (two copies of the same mutant allele) or compound heterozygotes (whereby each copy of a gene has a distinct mutant allele). Evidence: PCS. (PMID:34611029)
- Repeated implantation failure (HP:0033712): Repeated implantation failure refers to a situation in which embryos of good quality fail to implant following several in vitro fertilization (IVF) treatment cycles. Evidence: PCS. Frequency: 2/2. (PMID:34611029)
These phenotypes are associated with the disease oocyte maturation defect 13 (OMIM:620154).